- Atrioventricular dissociation (HP:0011709): Atrioventricular (AV) dissociation is present if the atria and the ventricles are under the control of two separate pacemakers. AV dissociation can occur in the absence of a primary AV conduction disturbance. Evidence: IEA. (OMIM:614954)
- Persistent left superior vena cava (HP:0005301): A rare congenital vascular anomaly that results when the left superior cardinal vein caudal to the innominate vein fails to regress. Evidence: TAS. (OMIM:614954)
- Atrial fibrillation (HP:0005110): An atrial arrhythmia characterized by disorganized atrial activity without discrete P waves on the surface EKG, but instead by an undulating baseline or more sharply circumscribed atrial deflections of varying amplitude an frequency ranging from 350 to 600 per minute. Evidence: TAS. (OMIM:614954)
- Tetralogy of Fallot (HP:0001636): A congenital cardiac malformation comprising pulmonary stenosis, overriding aorta, ventricular septum defect, and right ventricular hypertrophy. The diagnosis of TOF is made if at least three of the four above mentioned features are present. Evidence: TAS. (OMIM:614954)
- Complete right bundle branch block (HP:0011712): A conduction block of the right branch of the bundle of His. This manifests as a prolongation of the QRS complex (greater than 0.12 s) with delayed activation of the right ventricle and terminal delay on the EKG. Evidence: IEA. (OMIM:614954)
- Abnormal heart morphology (HP:0001627): Any structural anomaly of the heart. Evidence: IEA. (OMIM:614954)
- Tachycardia (HP:0001649): A rapid heartrate that exceeds the range of the normal resting heartrate for age. Evidence: IEA. (OMIM:614954)
- Atrial septal defect (HP:0001631): Atrial septal defect (ASD) is a congenital abnormality of the interatrial septum that enables blood flow between the left and right atria via the interatrial septum. Evidence: IEA. (OMIM:614954)
- Autosomal dominant inheritance (HP:0000006): A mode of inheritance that is observed for traits related to a gene encoded on one of the autosomes (i.e., the human chromosomes 1-22) in which a trait manifests in heterozygotes. In the context of medical genetics, an autosomal dominant disorder is caused when a single copy of the mutant allele is present. Males and females are affected equally, and can both transmit the disorder with a risk of 50% for each child of inheriting the mutant allele. Evidence: TAS. (OMIM:614954)
- Atrioventricular block (HP:0001678): Delayed or lack of conduction of atrial depolarizations through the atrioventricular node to the ventricles. Evidence: IEA. (OMIM:614954)
These phenotypes are associated with the disease congenital heart defects, multiple types, 3 (OMIM:614954).